- Autosomal dominant inheritance (HP:0000006): A mode of inheritance that is observed for traits related to a gene encoded on one of the autosomes (i.e., the human chromosomes 1-22) in which a trait manifests in heterozygotes. In the context of medical genetics, an autosomal dominant disorder is caused when a single copy of the mutant allele is present. Males and females are affected equally, and can both transmit the disorder with a risk of 50% for each child of inheriting the mutant allele. Evidence: TAS. (OMIM:125600)
- Abnormality of the skin (HP:0000951): An abnormality of the skin. Evidence: IEA. (OMIM:125600)
These phenotypes are associated with the disease dermatosis papulosa nigra (OMIM:125600).